Phenotypes associated with the disease Ring chromosome 14 syndrome (ORPHA:1440):
- Intellectual disability (HP:0001249): The term intellectual disability or intellectual developmental disorder is used to describe significantly sub-average intellectual and adaptive functioning based on clinical assessment and as measured by individually administered, appropriately normed, standardized and validated tests of intellectual functioning and adaptive behavior, with onset during the developmental period from infancy through adolescence. Evidence: TAS. Frequency: Very frequent (HP:0040281). (ORPHA:1440)
- Seizure (HP:0001250): A seizure is an intermittent abnormality of nervous system physiology characterized by a transient occurrence of signs and/or symptoms due to abnormal excessive or synchronous neuronal activity in the brain. Evidence: TAS. Frequency: Very frequent (HP:0040281). (ORPHA:1440)
- Atypical behavior (HP:0000708): Atypical behavior is an abnormality in a person's actions that can be controlled or modulated by the will of the individual. While abnormal behaviors can be difficult to control, they are distinct from other abnormal actions that cannot be affected by the individual's will. Evidence: TAS. Frequency: Frequent (HP:0040282). (ORPHA:1440)
- Delayed speech and language development (HP:0000750): A degree of language development that is significantly below the norm for a child of a specified age. Evidence: TAS. Frequency: Frequent (HP:0040282). (ORPHA:1440)
- Hypotonia (HP:0001252): Hypotonia is an abnormally low muscle tone (the amount of tension or resistance to movement in a muscle). Even when relaxed, muscles have a continuous and passive partial contraction which provides some resistance to passive stretching. Hypotonia thus manifests as diminished resistance to passive stretching. Hypotonia is not the same as muscle weakness, although the two conditions can co-exist. Evidence: TAS. Frequency: Frequent (HP:0040282). (ORPHA:1440)
- Motor delay (HP:0001270): A type of Developmental delay characterized by a delay in acquiring motor skills. Evidence: TAS. Frequency: Frequent (HP:0040282). (ORPHA:1440)
- Intrauterine growth retardation (HP:0001511): An abnormal restriction of fetal growth with fetal weight below the tenth percentile for gestational age. Evidence: TAS. Frequency: Frequent (HP:0040282). (ORPHA:1440)
- Recurrent infections (HP:0002719): Increased susceptibility to infections as manifested by repeated bouts of infection. Evidence: TAS. Frequency: Frequent (HP:0040282). (ORPHA:1440)
- Secondary microcephaly (HP:0005484): Head circumference which falls below 2 standard deviations below the mean for age and gender because of insufficient head growth after birth. Evidence: TAS. Frequency: Frequent (HP:0040282). (ORPHA:1440)
- Postnatal growth retardation (HP:0008897): Slow or limited growth after birth. Evidence: TAS. Frequency: Frequent (HP:0040282). (ORPHA:1440)
- Interictal EEG abnormality (HP:0025373): Interictal refers to a period of time between epileptic seizures. Electroencephalographic (EEG) patterns are important in the differential diagnosis of epilepsy, and the EEG is almost always abnormal during a seizure. Some persons with seizures may show EEG abnormalities between seizures, while others do not. In some cases, multiple interictal EEGs must be recorded before an abnormality is observed. In most cases the electrographic pattern of seizure onset is completely different from the activity recorded during interictal discharge. Evidence: TAS. Frequency: Frequent (HP:0040282). (ORPHA:1440)
- Strabismus (HP:0000486): A misalignment of the eyes so that the visual axes deviate from bifoveal fixation. The classification of strabismus may be based on a number of features including the relative position of the eyes, whether the deviation is latent or manifest, intermittent or constant, concomitant or otherwise and according to the age of onset and the relevance of any associated refractive error. Evidence: TAS. Frequency: Occasional (HP:0040283). (ORPHA:1440)
- Glaucoma (HP:0000501): Glaucoma refers loss of retinal ganglion cells in a characteristic pattern of optic neuropathy usually associated with increased intraocular pressure. Evidence: TAS. Frequency: Occasional (HP:0040283). (ORPHA:1440)
- Cataract (HP:0000518): A cataract is an opacity or clouding that develops in the crystalline lens of the eye or in its capsule. Evidence: TAS. Frequency: Occasional (HP:0040283). (ORPHA:1440)
- Myopia (HP:0000545): An abnormality of refraction characterized by the ability to see objects nearby clearly, while objects in the distance appear blurry. Evidence: TAS. Frequency: Occasional (HP:0040283). (ORPHA:1440)
- Iris coloboma (HP:0000612): A coloboma of the iris. Evidence: TAS. Frequency: Occasional (HP:0040283). (ORPHA:1440)
- Hyperactivity (HP:0000752): Hyperactivity is a condition characterized by constant and unusually high levels of activity, even in situations where it is deemed inappropriate. Evidence: TAS. Frequency: Occasional (HP:0040283). (ORPHA:1440)
- Cafe-au-lait spot (HP:0000957): Cafe-au-lait spots are hyperpigmented lesions that can vary in color from light brown to dark brown with smooth borders and having a size of 1.5 cm or more in adults and 0.5 cm or more in children. Evidence: TAS. Frequency: Occasional (HP:0040283). (ORPHA:1440)
- Abnormal corpus callosum morphology (HP:0001273): Abnormality of the corpus callosum. Evidence: TAS. Frequency: Occasional (HP:0040283). (ORPHA:1440)
- Scoliosis (HP:0002650): The presence of an abnormal lateral curvature of the spine. Evidence: TAS. Frequency: Occasional (HP:0040283). (ORPHA:1440)
- Abnormal retinal pigmentation (HP:0007703): Any deviation from the normal pigmentation of the retina. Evidence: TAS. Frequency: Occasional (HP:0040283). (ORPHA:1440)